- Stridor (HP:0010307): Stridor is a high pitched sound resulting from turbulent air flow in the upper airway. Evidence: TAS. Frequency: Very frequent (HP:0040281). (ORPHA:137935)
- Respiratory distress (HP:0002098): Respiratory distress is objectively observable as the physical or emotional consequences from the experience of dyspnea. The physical presentation of respiratory distress is generally referred to as labored breathing, while the sensation of respiratory distress is called shortness of breath or dyspnea. Evidence: TAS. Frequency: Frequent (HP:0040282). (ORPHA:137935)
- Feeding difficulties (HP:0011968): Impaired ability to eat related to problems gathering food and getting ready to suck, chew, or swallow it. Evidence: TAS. Frequency: Frequent (HP:0040282). (ORPHA:137935)
- Cough (HP:0012735): A sudden, audible expulsion of air from the lungs through a partially closed glottis, preceded by inhalation. Evidence: TAS. Frequency: Frequent (HP:0040282). (ORPHA:137935)
- Intercostal retractions (HP:0030864): A pulling inward of the soft tissues between the ribs upon inhalation. This is a sign of increased use of the chest muscles for breathing and is a manifestation of respiratory distress. Evidence: TAS. Frequency: Frequent (HP:0040282). (ORPHA:137935)
- Facial hemangioma (HP:0000329): Hemangioma, a benign tumor of the vascular endothelial cells, occurring in the face. Evidence: TAS. Frequency: Occasional (HP:0040283). (ORPHA:137935)
- Delayed speech and language development (HP:0000750): A degree of language development that is significantly below the norm for a child of a specified age. Evidence: TAS. Frequency: Occasional (HP:0040283). (ORPHA:137935)
- Cyanosis (HP:0000961): Bluish discoloration of the skin and mucosa due to poor circulation or inadequate oxygenation of arterial or capillary blood. Evidence: TAS. Frequency: Occasional (HP:0040283). (ORPHA:137935)
- Hoarse voice (HP:0001609): Hoarseness refers to a change in the pitch or quality of the voice, with the voice sounding weak, very breathy, scratchy, or husky. Evidence: TAS. Frequency: Occasional (HP:0040283). (ORPHA:137935)
- Wheezing (HP:0030828): A high-pitched whistling sound associated with labored breathing. Evidence: TAS. Frequency: Occasional (HP:0040283). (ORPHA:137935)
- Vomiting (HP:0002013): Forceful ejection of the contents of the stomach through the mouth by means of a series of involuntary spasmic contractions. Evidence: TAS. Frequency: Very rare (HP:0040284). (ORPHA:137935)
- Apnea (HP:0002104): Lack of breathing with no movement of the respiratory muscles and no exchange of air in the lungs. This term refers to a disposition to have recurrent episodes of apnea rather than to a single event. Evidence: TAS. Frequency: Very rare (HP:0040284). (ORPHA:137935)
- Sleep disturbance (HP:0002360): An abnormal pattern in the quality, quantity, or characteristics of sleep. Evidence: TAS. Frequency: Very rare (HP:0040284). (ORPHA:137935)
These phenotypes are associated with the disease Airway infantile hemangioma (ORPHA:137935).